- Clumsiness (HP:0002312): Lack of physical coordination resulting in an abnormal tendency to drop items or bump into objects. Evidence: IEA. (OMIM:608029)
- Congenital onset (HP:0003577): A phenotypic abnormality that is present at birth. Evidence: IEA. (OMIM:608029)
- Delayed speech and language development (HP:0000750): A degree of language development that is significantly below the norm for a child of a specified age. Evidence: IEA. (OMIM:608029)
- Dysmetria (HP:0001310): A type of ataxia characterized by the inability to carry out movements with the correct range and motion across the plane of more than one joint related to incorrect estimation of the distances required for targeted movements. Evidence: IEA. (OMIM:608029)
- Short stature (HP:0004322): A height below that which is expected according to age and gender norms. Although there is no universally accepted definition of short stature, many refer to "short stature" as height more than 2 standard deviations below the mean for age and gender (or below the 3rd percentile for age and gender dependent norms). Evidence: IEA. (OMIM:608029)
- Cerebellar atrophy (HP:0001272): Cerebellar atrophy is defined as a cerebellum with initially normal structures, in a posterior fossa with normal size, which displays enlarged fissures (interfolial spaces) in comparison to the foliae secondary to loss of tissue. Cerebellar atrophy implies irreversible loss of tissue and result from an ongoing progressive disease until a final stage is reached or a single injury, e.g. an intoxication or infectious event. Evidence: TAS. (OMIM:608029)
- Gait ataxia (HP:0002066): A type of ataxia characterized by the impairment of the ability to coordinate the movements required for normal walking. Gait ataxia is characteirzed by a wide-based staggering gait with a tendency to fall. Evidence: IEA. (OMIM:608029)
- Hypotonia (HP:0001252): Hypotonia is an abnormally low muscle tone (the amount of tension or resistance to movement in a muscle). Even when relaxed, muscles have a continuous and passive partial contraction which provides some resistance to passive stretching. Hypotonia thus manifests as diminished resistance to passive stretching. Hypotonia is not the same as muscle weakness, although the two conditions can co-exist. Evidence: IEA. (OMIM:608029)
- Nonprogressive (HP:0003680): Applies to a disease manifestation that does not increase in scope or severity over the course of time, i.e., that does not worsen with age. Evidence: IEA. (OMIM:608029)
- Ataxia (HP:0001251): Ataxia refers to impaired coordination of voluntary muscle movement. Cerebellar ataxia refers to ataxia due to dysfunction of the cerebellum. This causes a variety of elementary neurological deficits including asynergy (lack of coordination between muscles, limbs and joints), dysmetria (lack of ability to judge distances that can lead to under- or overshoot in grasping movements), and dysdiadochokinesia (inability to perform rapid movements requiring antagonizing muscle groups to be switched on and off repeatedly). Evidence: TAS. (OMIM:608029)
- Generalized hypotonia (HP:0001290): Generalized muscular hypotonia (abnormally low muscle tone). Evidence: TAS. (OMIM:608029)
- Motor delay (HP:0001270): A type of Developmental delay characterized by a delay in acquiring motor skills. Evidence: IEA. (OMIM:608029)
- Intention tremor (HP:0002080): A type of kinetic tremor that occurs during target directed movement is called intention tremor. That is, an oscillatory cerebellar ataxia that tends to be absent when the limbs are inactive and during the first part of voluntary movement but worsening as the movement continues and greater precision is required (e.g., in touching a target such as the patient's nose or a physician's finger). Evidence: IEA. (OMIM:608029)
- Autosomal recessive inheritance (HP:0000007): A mode of inheritance that is observed for traits related to a gene encoded on one of the autosomes (i.e., the human chromosomes 1-22) in which a trait manifests in individuals with two pathogenic alleles, either homozygotes (two copies of the same mutant allele) or compound heterozygotes (whereby each copy of a gene has a distinct mutant allele). Evidence: IEA. (OMIM:608029)
- Spasticity (HP:0001257): A motor disorder characterized by a velocity-dependent increase in tonic stretch reflexes with increased muscle tone, exaggerated (hyperexcitable) tendon reflexes. Evidence: TAS. (OMIM:608029)
- Pes planus (HP:0001763): A foot where the longitudinal arch of the foot is in contact with the ground or floor when the individual is standing; or, in a patient lying supine, a foot where the arch is in contact with the surface of a flat board pressed against the sole of the foot by the examiner with a pressure similar to that expected from weight bearing; or, the height of the arch is reduced. Evidence: IEA. (OMIM:608029)
- Hyperreflexia (HP:0001347): Hyperreflexia is the presence of hyperactive stretch reflexes of the muscles. Evidence: IEA. (OMIM:608029)
These phenotypes are associated with the disease infantile-onset autosomal recessive nonprogressive cerebellar ataxia (OMIM:608029).